- Sleep onset rapid eye movement period (HP:5200356): Entering REM sleep immediately upon falling asleep. Evidence: PCS. Frequency: 24/39. (PMID:36592569)
- Abnormal rapid eye movement sleep (HP:0002494): Abnormality of REM Sleep are phases of REM sleep are characterized by desynchronized EEG patterns, increases in heart rate and blood pressure, sympathetic activation, and a profound loss of muscle tone except for the eye and middle-ear muscles. There are also phases of rapid eye movements. Evidence: PCS. Frequency: 11/11. (PMID:10973318;OMIM:161400)
- Sleep attack (HP:0002330): A sleep attack is a sudden, irresistable episode of sleep that occurs during waking hours. Evidence: IEA. (OMIM:161400)
- Hypnagogic hallucination (HP:0002519): Hypnagogic hallucinations are brief hallucinations that occur when falling asleep. Evidence: PCS. Frequency: 1/1. (PMID:10973318)
- Excessive daytime somnolence (HP:0001262): A state of abnormally strong desire for sleep during the daytime. Evidence: PCS. Frequency: 1/1. (PMID:10973318)
- Sleep paralysis (HP:0025233): Inability to move trunk and limbs and inability to speak during transition into or out of sleep; awareness is preserved and recall is present. Evidence: PCS. Frequency: 31/40. (PMID:10973318;PMID:36592569)
- Infantile onset (HP:0003593): Onset of signs or symptoms of disease between 28 days to one year of life. Evidence: PCS. Frequency: 1/1. (PMID:10973318)
- Poor sleep (HP:4000064): Subjectively or observationally reported sleep that is insufficiently restorative, disrupted, or of inadequate quality, regardless of duration. Poor sleep may involve difficulty maintaining sleep continuity, frequent awakenings, a sense of light or shallow sleep, or waking up feeling unrefreshed. It is typically identified through self-report or clinical interview and not by objective measurements. Evidence: PCS. Frequency: 24/39. (PMID:36592569)
- Hypnopompic hallucination (HP:0006896): Hallucinations occurring during the transition from sleep to wakefulness. Evidence: IEA. (OMIM:161400)
- Cataplexy (HP:0002524): A sudden and transient episode of bilateral loss of muscle tone, often triggered by emotions. Evidence: PCS. Frequency: 39/40. (PMID:10973318;PMID:36592569)
- Autosomal dominant inheritance (HP:0000006): A mode of inheritance that is observed for traits related to a gene encoded on one of the autosomes (i.e., the human chromosomes 1-22) in which a trait manifests in heterozygotes. In the context of medical genetics, an autosomal dominant disorder is caused when a single copy of the mutant allele is present. Males and females are affected equally, and can both transmit the disorder with a risk of 50% for each child of inheriting the mutant allele. Evidence: PCS. (PMID:10973318)
These phenotypes are associated with the disease narcolepsy 1 (OMIM:161400).